- Abnormality of the dentition (HP:0000164): Any abnormality of the teeth. Evidence: TAS. Frequency: Frequent (HP:0040282). (ORPHA:3424)
- Narrow face (HP:0000275): Bizygomatic (upper face) and bigonial (lower face) width are both more than 2 standard deviations below the mean (objective); or, an apparent reduction in the width of the upper and lower face (subjective). Evidence: TAS. Frequency: Frequent (HP:0040282). (ORPHA:3424)
- Long face (HP:0000276): Facial height (length) is more than 2 standard deviations above the mean (objective); or, an apparent increase in the height (length) of the face (subjective). Evidence: TAS. Frequency: Very frequent (HP:0040281). (ORPHA:3424)
- Epicanthus (HP:0000286): A fold of skin starting above the medial aspect of the upper eyelid and arching downward to cover, pass in front of and lateral to the medial canthus. Evidence: TAS. Frequency: Very frequent (HP:0040281). (ORPHA:3424)
- Hypertelorism (HP:0000316): Interpupillary distance more than 2 SD above the mean (alternatively, the appearance of an increased interpupillary distance or widely spaced eyes). Evidence: TAS. Frequency: Frequent (HP:0040282). (ORPHA:3424)
- Facial asymmetry (HP:0000324): An abnormal difference between the left and right sides of the face. Evidence: TAS. Frequency: Frequent (HP:0040282). (ORPHA:3424)
- Wide nasal bridge (HP:0000431): Increased breadth of the nasal bridge (and with it, the nasal root). Evidence: TAS. Frequency: Very frequent (HP:0040281). (ORPHA:3424)
- Thickened nuchal skin fold (HP:0000474): A thickening of the skin thickness in the posterior aspect of the fetal neck. A nuchal fold (NF) measurement is obtained in a transverse section of the fetal head at the level of the cavum septum pellucidum and thalami, angled posteriorly to include the cerebellum. The measurement is taken from the outer edge of the occiput bone to the outer skin limit directly in the midline. An NF measurement greater than 5 mm at 14 to 17+6 weeks of gestation, or 6 mm at 18 to 28 weeks has been associated with a markedly increased risk for Down syndrome. Evidence: TAS. Frequency: Frequent (HP:0040282). (ORPHA:3424)
- Telecanthus (HP:0000506): Distance between the inner canthi more than two standard deviations above the mean (objective); or, apparently increased distance between the inner canthi. Evidence: TAS. Frequency: Frequent (HP:0040282). (ORPHA:3424)
- Abnormal thumb morphology (HP:0001172): An abnormal structure of the first digit of the hand. Evidence: TAS. Frequency: Frequent (HP:0040282). (ORPHA:3424)
- Large hands (HP:0001176). Evidence: TAS. Frequency: Frequent (HP:0040282). (ORPHA:3424)
- Prominent fingertip pads (HP:0001212): A soft tissue prominence of the ventral aspects of the fingertips. The term "persistent fetal fingertip pads" is often used as a synonym, but should better not be used because it implies knowledge of history of the patient which often does not exist. Evidence: TAS. Frequency: Frequent (HP:0040282). (ORPHA:3424)
- Premature birth (HP:0001622): The birth of a baby of less than 37 weeks of gestational age. Evidence: TAS. Frequency: Frequent (HP:0040282). (ORPHA:3424)
- High, narrow palate (HP:0002705): The presence of a high and narrow palate. Evidence: TAS. Frequency: Very frequent (HP:0040281). (ORPHA:3424)
- Delayed skeletal maturation (HP:0002750): A decreased rate of skeletal maturation. Delayed skeletal maturation can be diagnosed on the basis of an estimation of the bone age from radiographs of specific bones in the human body. Evidence: TAS. Frequency: Frequent (HP:0040282). (ORPHA:3424)
- Clinodactyly of the 5th finger (HP:0004209): Clinodactyly refers to a bending or curvature of the fifth finger in the radial direction (i.e., towards the 4th finger). Evidence: TAS. Frequency: Very frequent (HP:0040281). (ORPHA:3424)
- Short palm (HP:0004279): Short palm. Evidence: TAS. Frequency: Very frequent (HP:0040281). (ORPHA:3424)
- Short stature (HP:0004322): A height below that which is expected according to age and gender norms. Although there is no universally accepted definition of short stature, many refer to "short stature" as height more than 2 standard deviations below the mean for age and gender (or below the 3rd percentile for age and gender dependent norms). Evidence: TAS. Frequency: Very frequent (HP:0040281). (ORPHA:3424)
These phenotypes are associated with the disease Velo-facial-skeletal syndrome (ORPHA:3424).